Phenotypes associated with the disease Congenital heart defect-round face-developmental delay syndrome (ORPHA:1355):
- Narrow mouth (HP:0000160): Distance between the commissures of the mouth more than 2 SD below the mean. Alternatively, an apparently decreased width of the oral aperture (subjective). Evidence: TAS. Frequency: Very frequent (HP:0040281). (ORPHA:1355)
- Abnormal oral cavity morphology (HP:0000163): Abnormality of the oral cavity, i.e., the opening or hollow part of the mouth. Evidence: TAS. Frequency: Very frequent (HP:0040281). (ORPHA:1355)
- Round face (HP:0000311): The facial appearance is more circular than usual as viewed from the front. Evidence: TAS. Frequency: Very frequent (HP:0040281). (ORPHA:1355)
- Depressed nasal ridge (HP:0000457): Lack of prominence of the nose resulting from a posteriorly-placed nasal ridge. Evidence: TAS. Frequency: Very frequent (HP:0040281). (ORPHA:1355)
- Anteverted nares (HP:0000463): Anteriorly-facing nostrils viewed with the head in the Frankfurt horizontal and the eyes of the observer level with the eyes of the subject. This gives the appearance of an upturned nose (upturned nasal tip). Evidence: TAS. Frequency: Very frequent (HP:0040281). (ORPHA:1355)
- Short nose (HP:0003196): Distance from nasion to subnasale more than two standard deviations below the mean, or alternatively, an apparently decreased length from the nasal root to the nasal tip. Evidence: TAS. Frequency: Very frequent (HP:0040281). (ORPHA:1355)
- Short stature (HP:0004322): A height below that which is expected according to age and gender norms. Although there is no universally accepted definition of short stature, many refer to "short stature" as height more than 2 standard deviations below the mean for age and gender (or below the 3rd percentile for age and gender dependent norms). Evidence: TAS. Frequency: Very frequent (HP:0040281). (ORPHA:1355)
- Hypopigmentation of hair (HP:0005599). Evidence: TAS. Frequency: Very frequent (HP:0040281). (ORPHA:1355)
- Generalized hyperpigmentation (HP:0007440). Evidence: TAS. Frequency: Very frequent (HP:0040281). (ORPHA:1355)
- Abnormal dermatoglyphics (HP:0007477): An abnormality of dermatoglyphs (fingerprints), which are present on fingers, palms, toes, and soles. Evidence: TAS. Frequency: Very frequent (HP:0040281). (ORPHA:1355)
- Abnormal cardiovascular system morphology (HP:0030680): Any structural anomaly of the heart and blood vessels. Evidence: TAS. Frequency: Very frequent (HP:0040281). (ORPHA:1355)
- Hypospadias (HP:0000047): Abnormal position of urethral meatus on the ventral penile shaft (underside) characterized by displacement of the urethral meatus from the tip of the glans penis to the ventral surface of the penis, scrotum, or perineum. Evidence: TAS. Frequency: Frequent (HP:0040282). (ORPHA:1355)